- Aortic valve stenosis (HP:0001650): The presence of a stenosis (narrowing) of the aortic valve. Evidence: IEA. (DECIPHER:3)
- Everted lower lip vermilion (HP:0000232): An abnormal configuration of the lower lip such that it is turned outward i.e., everted, with the Inner aspect of the lower lip vermilion (normally opposing the teeth) being visible in a frontal view. Evidence: IEA. (DECIPHER:3)
- Short stature (HP:0004322): A height below that which is expected according to age and gender norms. Although there is no universally accepted definition of short stature, many refer to "short stature" as height more than 2 standard deviations below the mean for age and gender (or below the 3rd percentile for age and gender dependent norms). Evidence: IEA. (DECIPHER:3)
- Microdontia (HP:0000691): Decreased size of the teeth, which can be defined as a mesiodistal tooth diameter (width) more than 2 SD below mean. Alternatively, an apparently decreased maximum width of tooth. Evidence: IEA. (DECIPHER:3)
- Malar flattening (HP:0000272): Underdevelopment of the malar prominence of the jugal bone (zygomatic bone in mammals), appreciated in profile, frontal view, and/or by palpation. Evidence: IEA. (DECIPHER:3)
- Short attention span (HP:0000736): Reduced attention span characterized by distractibility and impulsivity. Evidence: IEA. (DECIPHER:3)
- Intellectual disability (HP:0001249): The term intellectual disability or intellectual developmental disorder is used to describe significantly sub-average intellectual and adaptive functioning based on clinical assessment and as measured by individually administered, appropriately normed, standardized and validated tests of intellectual functioning and adaptive behavior, with onset during the developmental period from infancy through adolescence. Evidence: IEA. (DECIPHER:3)
These phenotypes are associated with the disease Williams syndrome (DECIPHER:3).